- Facial flushing after alcohol intake (HP:0001033). Evidence: TAS. (OMIM:610251)
- Reduced acetaldehyde dehydrogenase level (HP:0003533): Decreased level of acetaldehyde dehydrogenase (ALDH). ALDH and alcohol dehydrogenase (ADH) are the primary enzymes involved in alcohol metabolism. Evidence: TAS. (OMIM:610251)
- Autosomal dominant inheritance (HP:0000006): A mode of inheritance that is observed for traits related to a gene encoded on one of the autosomes (i.e., the human chromosomes 1-22) in which a trait manifests in heterozygotes. In the context of medical genetics, an autosomal dominant disorder is caused when a single copy of the mutant allele is present. Males and females are affected equally, and can both transmit the disorder with a risk of 50% for each child of inheriting the mutant allele. Evidence: TAS. (OMIM:610251)
These phenotypes are associated with the disease alcohol sensitivity, acute (OMIM:610251).